Phenotypes associated with the disease ELECTROENCEPHALOGRAPHIC PATTERNS (OMIM:130190):
- EEG abnormality (HP:0002353): Abnormality observed by electroencephalogram (EEG), which is used to record of the brain's spontaneous electrical activity from multiple electrodes placed on the scalp. Evidence: IEA. (OMIM:130190)
- Autosomal dominant inheritance (HP:0000006): A mode of inheritance that is observed for traits related to a gene encoded on one of the autosomes (i.e., the human chromosomes 1-22) in which a trait manifests in heterozygotes. In the context of medical genetics, an autosomal dominant disorder is caused when a single copy of the mutant allele is present. Males and females are affected equally, and can both transmit the disorder with a risk of 50% for each child of inheriting the mutant allele. Evidence: IEA. (OMIM:130190)